Phenotypes associated with the disease tropical pancreatitis (OMIM:608189):
- Neoplasm of the pancreas (HP:0002894): A tumor (abnormal growth of tissue) of the pancreas. Evidence: IEA. (OMIM:608189)
- Chronic pancreatitis (HP:0006280): A chronic form of pancreatitis. Evidence: TAS. (OMIM:608189)
- Pancreatic calcification (HP:0005213): The presence of abnormal calcium deposition lesions in the pancreas. Evidence: TAS. Frequency: 20/20. (OMIM:608189)
- Autosomal recessive inheritance (HP:0000007): A mode of inheritance that is observed for traits related to a gene encoded on one of the autosomes (i.e., the human chromosomes 1-22) in which a trait manifests in individuals with two pathogenic alleles, either homozygotes (two copies of the same mutant allele) or compound heterozygotes (whereby each copy of a gene has a distinct mutant allele). Evidence: IEA. (OMIM:608189)
- Insulin-dependent but ketosis-resistant diabetes (HP:0008205): Ketosis-resistant diabetes is a synonym for type II diabetes. This term thus refers to a form of type II diabetes in which patients are dependent on insulin. Evidence: IEA. (OMIM:608189)
- Autosomal dominant inheritance (HP:0000006): A mode of inheritance that is observed for traits related to a gene encoded on one of the autosomes (i.e., the human chromosomes 1-22) in which a trait manifests in heterozygotes. In the context of medical genetics, an autosomal dominant disorder is caused when a single copy of the mutant allele is present. Males and females are affected equally, and can both transmit the disorder with a risk of 50% for each child of inheriting the mutant allele. Evidence: IEA. (OMIM:608189)
- Abdominal pain (HP:0002027): An unpleasant sensation characterized by physical discomfort (such as pricking, throbbing, or aching) and perceived to originate in the abdomen. Evidence: TAS. (OMIM:608189)